- Cryptorchidism (HP:0000028): Testis in inguinal canal. That is, absence of one or both testes from the scrotum owing to failure of the testis or testes to descend through the inguinal canal to the scrotum. Evidence: TAS. Frequency: Occasional (HP:0040283). (ORPHA:254346)
- Hypospadias (HP:0000047): Abnormal position of urethral meatus on the ventral penile shaft (underside) characterized by displacement of the urethral meatus from the tip of the glans penis to the ventral surface of the penis, scrotum, or perineum. Evidence: TAS. Frequency: Occasional (HP:0040283). (ORPHA:254346)
- Cleft palate (HP:0000175): Cleft palate is a developmental defect of the palate resulting from a failure of fusion of the palatine processes and manifesting as a separation of the roof of the mouth (soft and hard palate). Evidence: TAS. Frequency: Occasional (HP:0040283). (ORPHA:254346)
- Thin vermilion border (HP:0000233): Height of the vermilion of the medial part of the lip more than 2 SD below the mean, or apparently reduced height of the vermilion of the lip in the frontal view. The vermilion is the red part of the lips (and confusingly, the vermilion itself is also often referred to as being equivalent the lips). Evidence: TAS. Frequency: Frequent (HP:0040282). (ORPHA:254346)
- Brachycephaly (HP:0000248): An abnormality of skull shape characterized by a decreased anterior-posterior diameter. That is, a cephalic index greater than 81%. Alternatively, an apparently shortened anteroposterior dimension (length) of the head compared to width. Evidence: TAS. Frequency: Frequent (HP:0040282). (ORPHA:254346)
- Microcephaly (HP:0000252): Head circumference below 2 standard deviations below the mean for age and gender. Evidence: TAS. Frequency: Frequent (HP:0040282). (ORPHA:254346)
- Epicanthus (HP:0000286): A fold of skin starting above the medial aspect of the upper eyelid and arching downward to cover, pass in front of and lateral to the medial canthus. Evidence: TAS. Frequency: Frequent (HP:0040282). (ORPHA:254346)
- Hypertelorism (HP:0000316): Interpupillary distance more than 2 SD above the mean (alternatively, the appearance of an increased interpupillary distance or widely spaced eyes). Evidence: TAS. Frequency: Occasional (HP:0040283). (ORPHA:254346)
- Broad forehead (HP:0000337): Width of the forehead or distance between the frontotemporales is more than two standard deviations above the mean (objective); or apparently increased distance between the two sides of the forehead. Evidence: TAS. Frequency: Frequent (HP:0040282). (ORPHA:254346)
- Long philtrum (HP:0000343): Distance between nasal base and midline upper lip vermilion border more than 2 SD above the mean. Alternatively, an apparently increased distance between nasal base and midline upper lip vermilion border. Evidence: TAS. Frequency: Occasional (HP:0040283). (ORPHA:254346)
- Low-set ears (HP:0000369): Upper insertion of the ear to the scalp below an imaginary horizontal line drawn between the inner canthi of the eye and extending posteriorly to the ear. Evidence: TAS. Frequency: Frequent (HP:0040282). (ORPHA:254346)
- Conductive hearing impairment (HP:0000405): An abnormality of vibrational conductance of sound to the inner ear leading to impairment of sensory perception of sound. Evidence: TAS. Frequency: Occasional (HP:0040283). (ORPHA:254346)
- Sensorineural hearing impairment (HP:0000407): A type of hearing impairment in one or both ears related to an abnormal functionality of the cochlear nerve. Evidence: TAS. Frequency: Frequent (HP:0040282). (ORPHA:254346)
- Narrow nasal bridge (HP:0000446): Decreased width of the bony bridge of the nose. Evidence: TAS. Frequency: Frequent (HP:0040282). (ORPHA:254346)
- Anteverted nares (HP:0000463): Anteriorly-facing nostrils viewed with the head in the Frankfurt horizontal and the eyes of the observer level with the eyes of the subject. This gives the appearance of an upturned nose (upturned nasal tip). Evidence: TAS. Frequency: Frequent (HP:0040282). (ORPHA:254346)
- Short neck (HP:0000470): Diminished length of the neck. Evidence: TAS. Frequency: Frequent (HP:0040282). (ORPHA:254346)
- Strabismus (HP:0000486): A misalignment of the eyes so that the visual axes deviate from bifoveal fixation. The classification of strabismus may be based on a number of features including the relative position of the eyes, whether the deviation is latent or manifest, intermittent or constant, concomitant or otherwise and according to the age of onset and the relevance of any associated refractive error. Evidence: TAS. Frequency: Occasional (HP:0040283). (ORPHA:254346)
- Proptosis (HP:0000520): An eye that is protruding anterior to the plane of the face to a greater extent than is typical. Evidence: TAS. Frequency: Occasional (HP:0040283). (ORPHA:254346)
- Myopia (HP:0000545): An abnormality of refraction characterized by the ability to see objects nearby clearly, while objects in the distance appear blurry. Evidence: TAS. Frequency: Occasional (HP:0040283). (ORPHA:254346)
- Nystagmus (HP:0000639): Rhythmic, involuntary oscillations of one or both eyes related to abnormality in fixation, conjugate gaze, or vestibular mechanisms. Evidence: TAS. Frequency: Occasional (HP:0040283). (ORPHA:254346)
- Synophrys (HP:0000664): Meeting of the medial eyebrows in the midline. Evidence: TAS. Frequency: Frequent (HP:0040282). (ORPHA:254346)
- Hypodontia (HP:0000668): The absence of five or less teeth from the normal series by a failure to develop. Evidence: TAS. Frequency: Frequent (HP:0040282). (ORPHA:254346)
- Delayed speech and language development (HP:0000750): A degree of language development that is significantly below the norm for a child of a specified age. Evidence: TAS. Frequency: Very frequent (HP:0040281). (ORPHA:254346)
- Hyperactivity (HP:0000752): Hyperactivity is a condition characterized by constant and unusually high levels of activity, even in situations where it is deemed inappropriate. Evidence: TAS. Frequency: Frequent (HP:0040282). (ORPHA:254346)
- Hypothyroidism (HP:0000821): Deficiency of thyroid hormone. Evidence: TAS. Frequency: Occasional (HP:0040283). (ORPHA:254346)
- Precocious puberty (HP:0000826): The onset of secondary sexual characteristics before a normal age. Although it is difficult to define normal age ranges because of the marked variation with which puberty begins in normal children, precocious puberty can be defined as the onset of puberty before the age of 8 years in girls or 9 years in boys. Evidence: TAS. Frequency: Occasional (HP:0040283). (ORPHA:254346)
- Seizure (HP:0001250): A seizure is an intermittent abnormality of nervous system physiology characterized by a transient occurrence of signs and/or symptoms due to abnormal excessive or synchronous neuronal activity in the brain. Evidence: TAS. Frequency: Frequent (HP:0040282). (ORPHA:254346)
- Hypotonia (HP:0001252): Hypotonia is an abnormally low muscle tone (the amount of tension or resistance to movement in a muscle). Even when relaxed, muscles have a continuous and passive partial contraction which provides some resistance to passive stretching. Hypotonia thus manifests as diminished resistance to passive stretching. Hypotonia is not the same as muscle weakness, although the two conditions can co-exist. Evidence: TAS. Frequency: Frequent (HP:0040282). (ORPHA:254346)
- Global developmental delay (HP:0001263): A delay in the achievement of motor or mental milestones in the domains of development of a child, including motor skills, speech and language, cognitive skills, and social and emotional skills. This term should only be used to describe children younger than five years of age. Evidence: TAS. Frequency: Very frequent (HP:0040281). (ORPHA:254346)
- Craniosynostosis (HP:0001363): Craniosynostosis refers to the premature closure of the cranial sutures. Primary craniosynostosis refers to the closure of one or more sutures due to abnormalities in skull development, and secondary craniosynostosis results from failure of brain growth. Evidence: TAS. Frequency: Occasional (HP:0040283). (ORPHA:254346)
- Hepatic steatosis (HP:0001397): Steatosis is a term used to denote lipid accumulation within hepatocytes. Evidence: TAS. Frequency: Occasional (HP:0040283). (ORPHA:254346)
- Intrauterine growth retardation (HP:0001511): An abnormal restriction of fetal growth with fetal weight below the tenth percentile for gestational age. Evidence: TAS. Frequency: Frequent (HP:0040282). (ORPHA:254346)
- Obesity (HP:0001513): Accumulation of substantial excess body fat. Evidence: TAS. Frequency: Occasional (HP:0040283). (ORPHA:254346)
- Ventricular septal defect (HP:0001629): A hole between the two bottom chambers (ventricles) of the heart. The defect is centered around the most superior aspect of the ventricular septum. Evidence: TAS. Frequency: Occasional (HP:0040283). (ORPHA:254346)
- Atrial septal defect (HP:0001631): Atrial septal defect (ASD) is a congenital abnormality of the interatrial septum that enables blood flow between the left and right atria via the interatrial septum. Evidence: TAS. Frequency: Frequent (HP:0040282). (ORPHA:254346)
- Mitral regurgitation (HP:0001653): An abnormality of the mitral valve characterized by insufficiency or incompetence of the mitral valve resulting in retrograde leaking of blood through the mitral valve upon ventricular contraction. Evidence: TAS. Frequency: Occasional (HP:0040283). (ORPHA:254346)
- Aortic regurgitation (HP:0001659): An insufficiency of the aortic valve, leading to regurgitation (backward flow) of blood from the aorta into the left ventricle. Evidence: TAS. Frequency: Occasional (HP:0040283). (ORPHA:254346)
- Sandal gap (HP:0001852): A widely spaced gap between the first toe (the great toe) and the second toe. Evidence: TAS. Frequency: Occasional (HP:0040283). (ORPHA:254346)
- Toe clinodactyly (HP:0001863): Bending or curvature of a toe in the tibial direction (i.e., towards the big toe). Evidence: TAS. Frequency: Occasional (HP:0040283). (ORPHA:254346)
- Deep plantar creases (HP:0001869): The presence of unusually deep creases (ridges/wrinkles) on the skin of sole of foot. Evidence: TAS. Frequency: Occasional (HP:0040283). (ORPHA:254346)
- Hypoplasia of the corpus callosum (HP:0002079): Underdevelopment of the corpus callosum. Evidence: TAS. Frequency: Occasional (HP:0040283). (ORPHA:254346)
- Ventriculomegaly (HP:0002119): An increase in size of the ventricular system of the brain. Evidence: TAS. Frequency: Frequent (HP:0040282). (ORPHA:254346)
- Generalized hirsutism (HP:0002230): Abnormally increased hair growth over much of the entire body. Evidence: TAS. Frequency: Occasional (HP:0040283). (ORPHA:254346)
- Scoliosis (HP:0002650): The presence of an abnormal lateral curvature of the spine. Evidence: TAS. Frequency: Frequent (HP:0040282). (ORPHA:254346)
- Arthrogryposis multiplex congenita (HP:0002804): Multiple congenital contractures in different body areas. Evidence: TAS. Frequency: Occasional (HP:0040283). (ORPHA:254346)
- Kyphosis (HP:0002808): Exaggerated anterior convexity of the thoracic vertebral column. Evidence: TAS. Frequency: Occasional (HP:0040283). (ORPHA:254346)
- Hyperlipidemia (HP:0003077): An elevated lipid concentration in the blood. Evidence: TAS. Frequency: Occasional (HP:0040283). (ORPHA:254346)
- Clinodactyly of the 5th finger (HP:0004209): Clinodactyly refers to a bending or curvature of the fifth finger in the radial direction (i.e., towards the 4th finger). Evidence: TAS. Frequency: Frequent (HP:0040282). (ORPHA:254346)
- Short palm (HP:0004279): Short palm. Evidence: TAS. Frequency: Frequent (HP:0040282). (ORPHA:254346)
- Finger syndactyly (HP:0006101): Webbing or fusion of the fingers, involving soft parts only or including bone structure. Bony fusions are referred to as "bony" Syndactyly if the fusion occurs in a radio-ulnar axis. Fusions of bones of the fingers in a proximo-distal axis are referred to as "Symphalangism". Evidence: TAS. Frequency: Occasional (HP:0040283). (ORPHA:254346)
- Deep palmar crease (HP:0006191): Excessively deep creases of the palm. Evidence: TAS. Frequency: Occasional (HP:0040283). (ORPHA:254346)
- Aplasia/Hypoplasia of the cerebellar vermis (HP:0006817): Absence or underdevelopment of the vermis of cerebellum. Evidence: TAS. Frequency: Occasional (HP:0040283). (ORPHA:254346)
- Arrhythmia (HP:0011675): Any cardiac rhythm other than the normal sinus rhythm. Such a rhythm may be either of sinus or ectopic origin and either regular or irregular. An arrhythmia may be due to a disturbance in impulse formation or conduction or both. Evidence: TAS. Frequency: Frequent (HP:0040282). (ORPHA:254346)
- Self-injurious behavior (HP:0100716): Self-aggression. Evidence: TAS. Frequency: Occasional (HP:0040283). (ORPHA:254346)
- Abnormal pinna morphology (HP:0000377): An abnormality of the pinna, which is also referred to as the auricle or external ear. Evidence: TAS. Frequency: Frequent (HP:0040282). (ORPHA:254346)
These phenotypes are associated with the disease 19p13.12 microdeletion syndrome (ORPHA:254346).